Phenotypes associated with the disease Cryptogenic organizing pneumonia (ORPHA:1302, an Orphanet rare-disease identifier):
- Cough (HP:0012735, a Human Phenotype Ontology term): A sudden, audible expulsion of air from the lungs through a partially closed glottis, preceded by inhalation. Evidence: TAS. Frequency: Very frequent (HP:0040281, a Human Phenotype Ontology term). (ORPHA:1302)
- Parenchymal consolidation (HP:0032177, a Human Phenotype Ontology term): Consolidation refers to an exudate or other product of disease that replaces alveolar air, rendering the lung solid (as in infective pneumonia). Evidence: TAS. Frequency: Very frequent (HP:0040281, a Human Phenotype Ontology term). (ORPHA:1302)
- Fever (HP:0001945, a Human Phenotype Ontology term): Body temperature elevated above the normal range. Evidence: TAS. Frequency: Frequent (HP:0040282, a Human Phenotype Ontology term). (ORPHA:1302)
- Increased total leukocyte count (HP:0001974, a Human Phenotype Ontology term): An abnormal increase in the number of leukocytes in the blood. Evidence: TAS. Frequency: Frequent (HP:0040282, a Human Phenotype Ontology term). (ORPHA:1302)
- Anorexia (HP:0002039, a Human Phenotype Ontology term): Lack of desire to eat (loss of appetite). Evidence: TAS. Frequency: Frequent (HP:0040282, a Human Phenotype Ontology term). (ORPHA:1302)
- Restrictive ventilatory defect (HP:0002091, a Human Phenotype Ontology term): A functional defect characterized by reduced total lung capacity (TLC) not associated with abnormalities of expiratory airflow or airway resistance. Spirometrically, a restrictive defect is defined as FEV1 (forced expiratory volume in 1 second) and FVC (forced vital capacity) less than 80 per cent. Restrictive lung disease may be caused by alterations in lung parenchyma or because of a disease of the pleura, chest wall, or neuromuscular apparatus. Evidence: TAS. Frequency: Frequent (HP:0040282, a Human Phenotype Ontology term). (ORPHA:1302)
- Dyspnea (HP:0002094, a Human Phenotype Ontology term): Difficult or labored breathing. Dyspnea is a subjective feeling only the patient can rate, e.g., on a Borg scale. Evidence: TAS. Frequency: Frequent (HP:0040282, a Human Phenotype Ontology term). (ORPHA:1302)
- Elevated erythrocyte sedimentation rate (HP:0003565, a Human Phenotype Ontology term): An increased erythrocyte sedimentation rate (ESR). The ESR is a test that measures the distance that erythrocytes have fallen after one hour in a vertical column of anticoagulated blood under the influence of gravity. The ESR is a nonspecific finding. An elevation may indicate inflammation or may be caused by any condition that elevates fibrinogen. Evidence: TAS. Frequency: Frequent (HP:0040282, a Human Phenotype Ontology term). (ORPHA:1302)
- Increased total neutrophil count (HP:0011897, a Human Phenotype Ontology term): Abnormal increase of absolute number of neutrophils in the blood, per microliter, compared to a reference range for a given sex and age-group. Evidence: TAS. Frequency: Frequent (HP:0040282, a Human Phenotype Ontology term). (ORPHA:1302)
- Fatigue (HP:0012378, a Human Phenotype Ontology term): A subjective feeling of tiredness characterized by a lack of energy and motivation. Evidence: TAS. Frequency: Frequent (HP:0040282, a Human Phenotype Ontology term). (ORPHA:1302)
- Ground-glass opacification (HP:0025179, a Human Phenotype Ontology term): On chest radiographs, ground-glass opacity appears as an area of hazy increased lung opacity, usually extensive, within which margins of pulmonary vessels may be indistinct. On CT scans, it appears as hazy increased opacity of lung, with preservation of bronchial and vascular margins. It is caused by partial filling of airspaces, interstitial thickening (due to fluid, cells, and/or fibrosis), partial collapse of alveoli, increased capillary blood volume, or a combination of these, the common factor being the partial displacement of air. Ground-glass opacity is less opaque than consolidation, in which bronchovascular margins are obscured. Evidence: TAS. Frequency: Frequent (HP:0040282, a Human Phenotype Ontology term). (ORPHA:1302)
- Crackles (HP:0030830, a Human Phenotype Ontology term): Crackles are discontinuous, explosive, and nonmusical adventitious lung sounds normally heard in inspiration and sometimes during expiration. Crackles are usually classified as fine and coarse crackles based on their duration, loudness, pitch, timing in the respiratory cycle, and relationship to coughing and changing body position. Evidence: TAS. Frequency: Frequent (HP:0040282, a Human Phenotype Ontology term). (ORPHA:1302)
- Nonproductive cough (HP:0031246, a Human Phenotype Ontology term): A cough that does not produce phlegm or mucus. Evidence: TAS. Frequency: Frequent (HP:0040282, a Human Phenotype Ontology term). (ORPHA:1302)
- Cyanosis (HP:0000961, a Human Phenotype Ontology term): Bluish discoloration of the skin and mucosa due to poor circulation or inadequate oxygenation of arterial or capillary blood. Evidence: TAS. Frequency: Occasional (HP:0040283, a Human Phenotype Ontology term). (ORPHA:1302)
- Weight loss (HP:0001824, a Human Phenotype Ontology term): Reduction of total body weight. Evidence: TAS. Frequency: Occasional (HP:0040283, a Human Phenotype Ontology term). (ORPHA:1302)
- Hemoptysis (HP:0002105, a Human Phenotype Ontology term): Coughing up (expectoration) of blood or blood-streaked sputum from the larynx, trachea, bronchi, or lungs. Evidence: TAS. Frequency: Occasional (HP:0040283, a Human Phenotype Ontology term). (ORPHA:1302)
- Elevated circulating C-reactive protein concentration (HP:0011227, a Human Phenotype Ontology term): The concentration of C-reactive protein in the blood circulation is above the upper limit of normal. Evidence: TAS. Frequency: Occasional (HP:0040283, a Human Phenotype Ontology term). (ORPHA:1302)
- Wheezing (HP:0030828, a Human Phenotype Ontology term): A high-pitched whistling sound associated with labored breathing. Evidence: TAS. Frequency: Occasional (HP:0040283, a Human Phenotype Ontology term). (ORPHA:1302)
- Bronchial breath sound (HP:0031994, a Human Phenotype Ontology term): Bronchial breath sounds contain much higher frequency components than normal breath sounds due to alteration of the low pass filtering function of the alveoli, as occurs in consolidation. It is loud, hollow, and high pitch. Expiratory phase is longer than inspiratory phase with the inspiratory-expiratory ratio (I:E) changing from normal 3:1 to 1:2. There is distinct pause between inspiration and expiration due to absent alveolar phase. It is associated with whispering pectoriloquy. Evidence: TAS. Frequency: Occasional (HP:0040283, a Human Phenotype Ontology term). (ORPHA:1302)
- Abnormal sputum (HP:0032016, a Human Phenotype Ontology term): Abnormal appearance of material expectorated (coughed up) from the respiratory system and that is composed of mucus but may contain other substances such as pus, blood, microorganisms, and fibrin. Evidence: TAS. Frequency: Occasional (HP:0040283, a Human Phenotype Ontology term). (ORPHA:1302)
- Chest pain (HP:0100749, a Human Phenotype Ontology term): An unpleasant sensation characterized by physical discomfort (such as pricking, throbbing, or aching) localized to the chest. Evidence: TAS. Frequency: Occasional (HP:0040283, a Human Phenotype Ontology term). (ORPHA:1302)
- Respiratory distress (HP:0002098, a Human Phenotype Ontology term): Respiratory distress is objectively observable as the physical or emotional consequences from the experience of dyspnea. The physical presentation of respiratory distress is generally referred to as labored breathing, while the sensation of respiratory distress is called shortness of breath or dyspnea. Evidence: TAS. Frequency: Very rare (HP:0040284, a Human Phenotype Ontology term). (ORPHA:1302)
- Pneumothorax (HP:0002107, a Human Phenotype Ontology term): Accumulation of air in the pleural cavity leading to a partially or completely collapsed lung. Evidence: TAS. Frequency: Very rare (HP:0040284, a Human Phenotype Ontology term). (ORPHA:1302)
- Arthralgia (HP:0002829, a Human Phenotype Ontology term): Joint pain. Evidence: TAS. Frequency: Very rare (HP:0040284, a Human Phenotype Ontology term). (ORPHA:1302)
- Hypoxemia (HP:0012418, a Human Phenotype Ontology term): An abnormally low level of blood oxygen. Evidence: TAS. Frequency: Very rare (HP:0040284, a Human Phenotype Ontology term). (ORPHA:1302)
- Pneumomediastinum (HP:0025421, a Human Phenotype Ontology term): The presence of free air in the mediastinum. Evidence: TAS. Frequency: Very rare (HP:0040284, a Human Phenotype Ontology term). (ORPHA:1302)
- Night sweats (HP:0030166, a Human Phenotype Ontology term): Occurrence of excessive sweating during sleep. Evidence: TAS. Frequency: Very rare (HP:0040284, a Human Phenotype Ontology term). (ORPHA:1302)